Phenotypes associated with the disease systemic lupus erythematosus, susceptibility to, 6 (OMIM:609939):
- Pleuritis (HP:0002102): Inflammation of the pleura. Evidence: PCS. Frequency: 53/220. (PMID:9843983)
- Abnormality of the kidney (HP:0000077): An abnormality of the kidney. Evidence: PCS. Frequency: 32.3%. (PMID:16642431)
- Cutaneous photosensitivity (HP:0000992): An increased sensitivity of the skin to light. Photosensitivity may result in a rash upon exposure to the sun (which is known as photodermatosis). Photosensitivity can be diagnosed by phototests in which light is shone on small areas of skin. Evidence: PCS. Frequency: 76.3%. (PMID:16642431)
- Miscarriage (HP:0005268): A pregnancy that ends at a stage in which the fetus is incapable of surviving on its own, defined as the spontaneous loss of a fetus before the 22th week of pregnancy. Evidence: PCS. Frequency: 13/220. (PMID:9843983)
- Antinuclear antibody positivity (HP:0003493): The presence of autoantibodies in the serum that react against nuclei or nuclear components. Evidence: PCS. Frequency: 98/220. (PMID:9843983)
- Malar rash (HP:0025300): An erythematous (red), flat facial rash that affects the skin in the malar area (over the cheekbones) and extends over the bridge of the nose. Evidence: PCS. Frequency: 66%. (PMID:16642431)
- Polygenic inheritance (HP:0010982): A mode of inheritance that depends on a mixture of major and minor genetic determinants possibly together with environmental factors. Diseases inherited in this manner are termed complex diseases. Evidence: TAS. (OMIM:609939)
- Abnormal renal physiology (HP:0012211): An abnormal functionality of the kidney. Evidence: PCS. Frequency: 30/220. (PMID:9843983)
- Abnormality of the nervous system (HP:0000707): An abnormality of the nervous system. Evidence: PCS. Frequency: 24.3%. (PMID:16642431)
- Abnormality of the immune system (HP:0002715): An abnormality of the immune system. Evidence: PCS. Frequency: 56.6%. (PMID:16642431)
- Pericarditis (HP:0001701): Inflammation of the sac-like covering around the heart (pericardium). Evidence: PCS. Frequency: 18/220. (PMID:9843983)
- Systemic lupus erythematosus (HP:0002725): A chronic, relapsing, inflammatory, and often febrile multisystemic disorder of connective tissue, characterized principally by involvement of the skin, joints, kidneys, and serosal membranes. Evidence: PCS. Frequency: 76.3%. (PMID:9843983)
- Arthritis (HP:0001369): Inflammation of a joint. Evidence: PCS. Frequency: 85/220. (PMID:9843983)
- Arthritis (HP:0001369): Inflammation of a joint. Evidence: PCS. Frequency: 78.3%. (PMID:9843983)
- Abnormality of the skin (HP:0000951): An abnormality of the skin. Evidence: PCS. Frequency: 91/220. (PMID:9843983)